Phenotypes associated with the disease chromosome 1p36 deletion syndrome (DECIPHER:18):
- Seizure (HP:0001250): A seizure is an intermittent abnormality of nervous system physiology characterized by a transient occurrence of signs and/or symptoms due to abnormal excessive or synchronous neuronal activity in the brain. Evidence: IEA. (DECIPHER:18)
- Deeply set eye (HP:0000490): An eye that is more deeply recessed into the plane of the face than is typical. Evidence: IEA. (DECIPHER:18)
- Delayed cranial suture closure (HP:0000270): Infants normally have two fontanels at birth, the diamond-shaped anterior fontanelle at the junction of the coronal and sagittal sutures, and the posterior fontanelle at the intersection of the occipital and parietal bones. The posterior fontanelle usually closes by the 8th week of life, and the anterior fontanel closes by the 18th month of life on average. This term applies if there is delay of closure of the fontanelles beyond the normal age. Evidence: IEA. (DECIPHER:18)
- Hypotonia (HP:0001252): Hypotonia is an abnormally low muscle tone (the amount of tension or resistance to movement in a muscle). Even when relaxed, muscles have a continuous and passive partial contraction which provides some resistance to passive stretching. Hypotonia thus manifests as diminished resistance to passive stretching. Hypotonia is not the same as muscle weakness, although the two conditions can co-exist. Evidence: IEA. (DECIPHER:18)
- Pointed chin (HP:0000307): A marked tapering of the lower face to the chin. Evidence: IEA. (DECIPHER:18)
- Intellectual disability (HP:0001249): The term intellectual disability or intellectual developmental disorder is used to describe significantly sub-average intellectual and adaptive functioning based on clinical assessment and as measured by individually administered, appropriately normed, standardized and validated tests of intellectual functioning and adaptive behavior, with onset during the developmental period from infancy through adolescence. Evidence: IEA. (DECIPHER:18)